- Vesicoureteral reflux (HP:0000076): Abnormal (retrograde) movement of urine from the bladder into ureters or kidneys related to inadequacy of the valvular mechanism at the ureterovesicular junction or other causes. Evidence: TAS. (OMIM:617219)
- Hip dysplasia (HP:0001385): The presence of developmental dysplasia of the hip. Evidence: TAS. (OMIM:617219)
- Talipes equinovarus (HP:0001762): Talipes equinovarus (also called clubfoot) typically has four main components: inversion and adduction of the forefoot; inversion of the heel and hindfoot; equinus (limitation of extension) of the ankle and subtalar joint; and internal rotation of the leg. Evidence: TAS. (OMIM:617219)
- Absent speech (HP:0001344): Complete lack of development of speech and language abilities. Evidence: IEA. (OMIM:617219)
- Feeding difficulties (HP:0011968): Impaired ability to eat related to problems gathering food and getting ready to suck, chew, or swallow it. Evidence: TAS. (OMIM:617219)
- Pyloric stenosis (HP:0002021): Pyloric stenosis, also known as infantile hypertrophic pyloric stenosis, is an uncommon condition in infants characterized by abnormal thickening of the pylorus muscles in the stomach leading to gastric outlet obstruction. Clinically infants are well at birth. Then, at 3 to 6 weeks of age, the infants present with projectile vomiting, potentially leading to dehydration and weight loss. Evidence: TAS. (OMIM:617219)
- Seizure (HP:0001250): A seizure is an intermittent abnormality of nervous system physiology characterized by a transient occurrence of signs and/or symptoms due to abnormal excessive or synchronous neuronal activity in the brain. Evidence: TAS. Frequency: Occasional (HP:0040283). (OMIM:617219)
- Hydroureter (HP:0000072): The distention of the ureter with urine. Evidence: TAS. (OMIM:617219)
- Global developmental delay (HP:0001263): A delay in the achievement of motor or mental milestones in the domains of development of a child, including motor skills, speech and language, cognitive skills, and social and emotional skills. This term should only be used to describe children younger than five years of age. Evidence: TAS. (OMIM:617219)
- Generalized hypotonia (HP:0001290): Generalized muscular hypotonia (abnormally low muscle tone). Evidence: TAS. (OMIM:617219)
- Tapered finger (HP:0001182): The gradual reduction in girth of the finger from proximal to distal. Evidence: TAS. (OMIM:617219)
- Typified by incomplete penetrance (HP:0003829): Description of conditions in which not all individuals with a given genotype exhibit the disease. Penetrance is the proportion that develop disease given a lifespan of 80 years. Evidence: TAS. (OMIM:617219)
- Vascular dilatation (HP:0002617): An abnormal increase in the diameter of an artery or vein, either as a diffuse dilatation or as a localized, sac-like outpouching of the vessel wall (aneurysm). Evidence: IEA. (OMIM:617219)
- Postnatal growth retardation (HP:0008897): Slow or limited growth after birth. Evidence: TAS. (OMIM:617219)
- Clinodactyly of the 5th finger (HP:0004209): Clinodactyly refers to a bending or curvature of the fifth finger in the radial direction (i.e., towards the 4th finger). Evidence: TAS. (OMIM:617219)
- Kidney stone (HP:0000787): Kidney stones (calculi) are mineral concretions in the renal calyces and pelvis that are found free or attached to the renal papillae. Evidence: TAS. (OMIM:617219)
- Autosomal dominant inheritance (HP:0000006): A mode of inheritance that is observed for traits related to a gene encoded on one of the autosomes (i.e., the human chromosomes 1-22) in which a trait manifests in heterozygotes. In the context of medical genetics, an autosomal dominant disorder is caused when a single copy of the mutant allele is present. Males and females are affected equally, and can both transmit the disorder with a risk of 50% for each child of inheriting the mutant allele. Evidence: TAS. (OMIM:617219)
- Intellectual disability (HP:0001249): The term intellectual disability or intellectual developmental disorder is used to describe significantly sub-average intellectual and adaptive functioning based on clinical assessment and as measured by individually administered, appropriately normed, standardized and validated tests of intellectual functioning and adaptive behavior, with onset during the developmental period from infancy through adolescence. Evidence: TAS. (OMIM:617219)
These phenotypes are associated with the disease chromosome 19q13.11 deletion syndrome, proximal (OMIM:617219).